- Impotence (HP:0000802, a Human Phenotype Ontology term): Inability to develop or maintain an erection of the penis. Evidence: TAS. Frequency: Frequent (HP:0040282, a Human Phenotype Ontology term). (ORPHA:91354)
- Oligomenorrhea (HP:0000876, a Human Phenotype Ontology term): Infrequent menses (less than 6 per year or more than 35 days between cycles). Evidence: TAS. Frequency: Frequent (HP:0040282, a Human Phenotype Ontology term). (ORPHA:91354)
- Headache (HP:0002315, a Human Phenotype Ontology term): Cephalgia, or pain sensed in various parts of the head, not confined to the area of distribution of any nerve. Evidence: TAS. Frequency: Frequent (HP:0040282, a Human Phenotype Ontology term). (ORPHA:91354)
- Decreased response to growth hormone stimulation test (HP:0000824, a Human Phenotype Ontology term): Insufficient responses to growth hormone (GH) provocation tests. GH deficiency is defined as a serum peak GH concentration less than 10 ng/mL on provocation with a combination of at least two separate stimulation tests. Evidence: TAS. Frequency: Occasional (HP:0040283, a Human Phenotype Ontology term). (ORPHA:91354)
- Precocious puberty (HP:0000826, a Human Phenotype Ontology term): The onset of secondary sexual characteristics before a normal age. Although it is difficult to define normal age ranges because of the marked variation with which puberty begins in normal children, precocious puberty can be defined as the onset of puberty before the age of 8 years in girls or 9 years in boys. Evidence: TAS. Frequency: Occasional (HP:0040283, a Human Phenotype Ontology term). (ORPHA:91354)
- Increased circulating prolactin concentration (HP:0000870, a Human Phenotype Ontology term): The presence of abnormally increased levels of prolactin in the blood. Prolactin is a peptide hormone produced by the anterior pituitary gland that plays a role in breast development and lactation during pregnancy. Evidence: TAS. Frequency: Occasional (HP:0040283, a Human Phenotype Ontology term). (ORPHA:91354)
- Seizure (HP:0001250, a Human Phenotype Ontology term): A seizure is an intermittent abnormality of nervous system physiology characterized by a transient occurrence of signs and/or symptoms due to abnormal excessive or synchronous neuronal activity in the brain. Evidence: TAS. Frequency: Occasional (HP:0040283, a Human Phenotype Ontology term). (ORPHA:91354)
- Abnormal cerebrospinal fluid morphology (HP:0002921, a Human Phenotype Ontology term): An abnormality of the cerebrospinal fluid (CSF). Evidence: TAS. Frequency: Occasional (HP:0040283, a Human Phenotype Ontology term). (ORPHA:91354)
- Autoimmunity (HP:0002960, a Human Phenotype Ontology term): The occurrence of an immune reaction against the organism's own cells or tissues. Evidence: TAS. Frequency: Occasional (HP:0040283, a Human Phenotype Ontology term). (ORPHA:91354)
- Reduced visual acuity (HP:0007663, a Human Phenotype Ontology term). Evidence: TAS. Frequency: Occasional (HP:0040283, a Human Phenotype Ontology term). (ORPHA:91354)
- Pituitary hypothyroidism (HP:0008245, a Human Phenotype Ontology term): A type of hypothyroidism that results from a defect in thyroid-stimulating hormone secretion. Evidence: TAS. Frequency: Occasional (HP:0040283, a Human Phenotype Ontology term). (ORPHA:91354)
- Abnormality of mental function (HP:0011446, a Human Phenotype Ontology term): Cognitive, psychiatric, or memory anomaly. Evidence: TAS. Frequency: Occasional (HP:0040283, a Human Phenotype Ontology term). (ORPHA:91354)
- Adrenocorticotropic hormone deficiency (HP:0011748, a Human Phenotype Ontology term): A reduced ability to secrete adrenocorticotropic hormone (ACTH), a hormone that stimulates the adrenal cortex to secrete of glucocorticoids such as cortisol. Evidence: TAS. Frequency: Occasional (HP:0040283, a Human Phenotype Ontology term). (ORPHA:91354)
- Visual acuity test abnormality (HP:0030532, a Human Phenotype Ontology term). Evidence: TAS. Frequency: Occasional (HP:0040283, a Human Phenotype Ontology term). (ORPHA:91354)
- Hypopituitarism (HP:0040075, a Human Phenotype Ontology term). Evidence: TAS. Frequency: Occasional (HP:0040283, a Human Phenotype Ontology term). (ORPHA:91354)
- Diplopia (HP:0000651, a Human Phenotype Ontology term): Diplopia is a condition in which a single object is perceived as two images, it is also known as double vision. Evidence: TAS. Frequency: Very rare (HP:0040284, a Human Phenotype Ontology term). (ORPHA:91354)
- Central diabetes insipidus (HP:0000863, a Human Phenotype Ontology term): A form of diabetes insipidus related to a failure of vasopressin (AVP) release from the hypothalamus. Evidence: TAS. Frequency: Very rare (HP:0040284, a Human Phenotype Ontology term). (ORPHA:91354)
- Hypotension (HP:0002615, a Human Phenotype Ontology term): Low Blood Pressure, vascular hypotension. Evidence: TAS. Frequency: Very rare (HP:0040284, a Human Phenotype Ontology term). (ORPHA:91354)
- Hyponatremia (HP:0002902, a Human Phenotype Ontology term): The concentration of sodium in the blood circulation is below the lower limit of normal. Evidence: TAS. Frequency: Very rare (HP:0040284, a Human Phenotype Ontology term). (ORPHA:91354)
- Trigeminal neuralgia (HP:0100661, a Human Phenotype Ontology term): A neuropathic disorder characterized by episodes of intense pain in the face, originating from the trigeminal nerve. One, two, or all three branches of the nerve may be affected. Evidence: TAS. Frequency: Very rare (HP:0040284, a Human Phenotype Ontology term). (ORPHA:91354)
These phenotypes are associated with the disease Pituitary deficiency due to empty sella turcica syndrome (ORPHA:91354, an Orphanet rare-disease identifier).
The following phenotypes are NOT associated with this disease:
- Pituitary adenoma (HP:0002893, a Human Phenotype Ontology term): A benign epithelial tumor derived from intrinsic cells of the adenohypophysis (anterior pituitary). Evidence: TAS. (ORPHA:91354)